Phenotypes associated with the disease immunodeficiency 39 (OMIM:616345):
- Childhood onset (HP:0011463): Onset of disease at the age of between 1 and 5 years. Evidence: PCS. Frequency: 1/1. (PMID:25814066)
- Autosomal recessive inheritance (HP:0000007): A mode of inheritance that is observed for traits related to a gene encoded on one of the autosomes (i.e., the human chromosomes 1-22) in which a trait manifests in individuals with two pathogenic alleles, either homozygotes (two copies of the same mutant allele) or compound heterozygotes (whereby each copy of a gene has a distinct mutant allele). Evidence: PCS. (PMID:25814066)
- Severe influenza infection (HP:0034249): An unusually severe infection by an influenza virus. Evidence: PCS. Frequency: 1/1. (PMID:25814066)
- Immunodeficiency (HP:0002721): Failure of the immune system to protect the body adequately from infection, due to the absence or insufficiency of some component process or substance. Evidence: PCS. (PMID:25814066)